Phenotypes associated with the disease diarrhea 14, congenital (OMIM:621160):
- Diarrhea (HP:0002014): Abnormally increased frequency (usually defined as three or more) loose or watery bowel movements a day. Evidence: PCS. Frequency: 2/2. (PMID:40174224)
- Congenital onset (HP:0003577): A phenotypic abnormality that is present at birth. Evidence: PCS. Frequency: 2/2. (PMID:40174224)
- Dependency on parenteral nutrition (HP:0033994): Inability to ingest sufficient quantities of nutrition by mouth or by tube-feeding with the corresponding requirement for intravenous administration of nutrition. Evidence: PCS. Frequency: 2/2. (PMID:40174224)
- Autosomal recessive inheritance (HP:0000007): A mode of inheritance that is observed for traits related to a gene encoded on one of the autosomes (i.e., the human chromosomes 1-22) in which a trait manifests in individuals with two pathogenic alleles, either homozygotes (two copies of the same mutant allele) or compound heterozygotes (whereby each copy of a gene has a distinct mutant allele). Evidence: PCS. (PMID:40174224)